Phenotypes associated with the disease intellectual disability, autosomal recessive 43 (OMIM:615817):
- Highly arched eyebrow (HP:0002553): Increased height of the central portion of the eyebrow, forming a crescent, semicircular, or inverted U shape. Evidence: PCS. Frequency: 1/2. (PMID:34599609)
- Microcephaly (HP:0000252): Head circumference below 2 standard deviations below the mean for age and gender. Evidence: PCS. Frequency: 1/2. (PMID:34599609)
- Delayed speech and language development (HP:0000750): A degree of language development that is significantly below the norm for a child of a specified age. Evidence: PCS. Frequency: 9/9. (PMID:21498477;PMID:34599609)
- Strabismus (HP:0000486): A misalignment of the eyes so that the visual axes deviate from bifoveal fixation. The classification of strabismus may be based on a number of features including the relative position of the eyes, whether the deviation is latent or manifest, intermittent or constant, concomitant or otherwise and according to the age of onset and the relevance of any associated refractive error. Evidence: PCS. Frequency: 1/2. (PMID:34599609)
- Short stature (HP:0004322): A height below that which is expected according to age and gender norms. Although there is no universally accepted definition of short stature, many refer to "short stature" as height more than 2 standard deviations below the mean for age and gender (or below the 3rd percentile for age and gender dependent norms). Evidence: PCS. Frequency: 9/9. (PMID:21498477;PMID:34599609)
- Delayed ability to walk (HP:0031936): A failure to achieve the ability to walk at an appropriate developmental stage. Most children learn to walk in a series of stages, and learn to walk short distances independently between 12 and 15 months. Evidence: PCS. Frequency: 2/2. (PMID:34599609)
- Profound intellectual disability (HP:0002187): Profound intellectual disability (ID) is defined as a type of ID characterized by profoundly sub-average adaptive functioning and intellectual functioning, with an intelligence quotient (IQ) below 20. Evidence: PCS. Frequency: 2/2. (PMID:34599609)
- Global developmental delay (HP:0001263): A delay in the achievement of motor or mental milestones in the domains of development of a child, including motor skills, speech and language, cognitive skills, and social and emotional skills. This term should only be used to describe children younger than five years of age. Evidence: PCS. Frequency: 7/7. (PMID:21498477)
- Hypotonia (HP:0001252): Hypotonia is an abnormally low muscle tone (the amount of tension or resistance to movement in a muscle). Even when relaxed, muscles have a continuous and passive partial contraction which provides some resistance to passive stretching. Hypotonia thus manifests as diminished resistance to passive stretching. Hypotonia is not the same as muscle weakness, although the two conditions can co-exist. Evidence: PCS. Frequency: 2/2. (PMID:34599609)
- Infantile onset (HP:0003593): Onset of signs or symptoms of disease between 28 days to one year of life. Evidence: PCS. Frequency: 7/7. (PMID:21498477)
- Delayed fine motor development (HP:0010862): A type of motor delay characterized by a delay in acquiring the ability to control the fingers and hands. Evidence: PCS. Frequency: 7/7. (PMID:21498477)
- Profound global developmental delay (HP:0012736): A profound delay in the achievement of motor or mental milestones in the domains of development of a child. Evidence: PCS. Frequency: 2/2. (PMID:34599609)
- Dorsal hirsutism (HP:0034042): Abnormally increased hair growth in the lskin of the back. Evidence: PCS. Frequency: 1/2. (PMID:34599609)
- Prominent forehead (HP:0011220): Forward prominence of the entire forehead, due to protrusion of the frontal bone. Evidence: PCS. Frequency: 1/2. (PMID:34599609)
- Autosomal recessive inheritance (HP:0000007): A mode of inheritance that is observed for traits related to a gene encoded on one of the autosomes (i.e., the human chromosomes 1-22) in which a trait manifests in individuals with two pathogenic alleles, either homozygotes (two copies of the same mutant allele) or compound heterozygotes (whereby each copy of a gene has a distinct mutant allele). Evidence: PCS. (PMID:21498477)
- Self-injurious behavior (HP:0100716): Self-aggression. Evidence: PCS. Frequency: 1/2. (PMID:34599609)
- Thin upper lip vermilion (HP:0000219): Height of the vermilion of the upper lip in the midline more than 2 SD below the mean. Alternatively, an apparently reduced height of the vermilion of the upper lip in the frontal view (subjective). Evidence: PCS. Frequency: 1/2. (PMID:34599609)
- Broad nasal tip (HP:0000455): Increase in width of the nasal tip. Evidence: PCS. Frequency: 2/2. (PMID:34599609)
- Spasticity (HP:0001257): A motor disorder characterized by a velocity-dependent increase in tonic stretch reflexes with increased muscle tone, exaggerated (hyperexcitable) tendon reflexes. Evidence: PCS. Frequency: 1/7. (PMID:21498477)
- Intellectual disability (HP:0001249): The term intellectual disability or intellectual developmental disorder is used to describe significantly sub-average intellectual and adaptive functioning based on clinical assessment and as measured by individually administered, appropriately normed, standardized and validated tests of intellectual functioning and adaptive behavior, with onset during the developmental period from infancy through adolescence. Evidence: PCS. Frequency: 7/7. (PMID:21498477)
- Low-set ears (HP:0000369): Upper insertion of the ear to the scalp below an imaginary horizontal line drawn between the inner canthi of the eye and extending posteriorly to the ear. Evidence: PCS. Frequency: 1/2. (PMID:34599609)
- Neonatal onset (HP:0003623): Onset of signs or symptoms of disease within the first 28 days of life. Evidence: PCS. Frequency: 2/2. (PMID:34599609)